- Posteriorly rotated ears (HP:0000358): A type of abnormal location of the ears in which the position of the ears is characterized by posterior rotation (the superior part of the ears is rotated towards the back of the head, and the inferior part of the ears towards the front). Evidence: TAS. Frequency: Very frequent (HP:0040281). (ORPHA:1133)
- Abnormality of the ureter (HP:0000069): An abnormality of the ureter. The ureter is the duct by which urine passes from the kidney to the bladder. Evidence: TAS. Frequency: Very frequent (HP:0040281). (ORPHA:1133)
- Narrow mouth (HP:0000160): Distance between the commissures of the mouth more than 2 SD below the mean. Alternatively, an apparently decreased width of the oral aperture (subjective). Evidence: TAS. Frequency: Very frequent (HP:0040281). (ORPHA:1133)
- Mandibular prognathia (HP:0000303): Abnormal prominence of the chin related to increased length of the mandible. Evidence: TAS. Frequency: Very frequent (HP:0040281). (ORPHA:1133)
- Smooth philtrum (HP:0000319): Flat skin surface, with no ridge formation in the central region of the upper lip between the nasal base and upper vermilion border. Evidence: TAS. Frequency: Very frequent (HP:0040281). (ORPHA:1133)
- Upslanted palpebral fissure (HP:0000582): The palpebral fissure inclination is more than two standard deviations above the mean for age (objective); or, the inclination of the palpebral fissure is greater than typical for age. Evidence: TAS. Frequency: Very frequent (HP:0040281). (ORPHA:1133)
- Abnormal dental enamel morphology (HP:0000682): An abnormality of the dental enamel. Evidence: TAS. Frequency: Very frequent (HP:0040281). (ORPHA:1133)
- Brachydactyly (HP:0001156): Digits that appear disproportionately short compared to the hand/foot. The word brachydactyly is used here to describe a series distinct patterns of shortened digits (brachydactyly types A-E). This is the sense used here. Evidence: TAS. Frequency: Very frequent (HP:0040281). (ORPHA:1133)
- Intrauterine growth retardation (HP:0001511): An abnormal restriction of fetal growth with fetal weight below the tenth percentile for gestational age. Evidence: TAS. Frequency: Very frequent (HP:0040281). (ORPHA:1133)
- Splenomegaly (HP:0001744): Abnormal increased size of the spleen. Evidence: TAS. Frequency: Very frequent (HP:0040281). (ORPHA:1133)
- Sparse body hair (HP:0002231): Sparseness of the body hair. Evidence: TAS. Frequency: Very frequent (HP:0040281). (ORPHA:1133)
- Hepatomegaly (HP:0002240): Abnormally increased size of the liver. Evidence: TAS. Frequency: Very frequent (HP:0040281). (ORPHA:1133)
- Abnormal pelvic girdle bone morphology (HP:0002644): An abnormality of the bony pelvic girdle, which is a ring of bones connecting the vertebral column to the femurs. Evidence: TAS. Frequency: Very frequent (HP:0040281). (ORPHA:1133)
- Scoliosis (HP:0002650): The presence of an abnormal lateral curvature of the spine. Evidence: TAS. Frequency: Very frequent (HP:0040281). (ORPHA:1133)
- Short stature (HP:0004322): A height below that which is expected according to age and gender norms. Although there is no universally accepted definition of short stature, many refer to "short stature" as height more than 2 standard deviations below the mean for age and gender (or below the 3rd percentile for age and gender dependent norms). Evidence: TAS. Frequency: Very frequent (HP:0040281). (ORPHA:1133)
- Cachexia (HP:0004326): Severe weight loss, wasting of muscle, loss of appetite, and general debility related to a chronic disease. Evidence: TAS. Frequency: Very frequent (HP:0040281). (ORPHA:1133)
- Craniofacial hyperostosis (HP:0004493): Excessive growth of the craniofacial bones. Evidence: TAS. Frequency: Very frequent (HP:0040281). (ORPHA:1133)
- Refractory anemia with ringed sideroblasts (HP:0004828): A type of myelodysplastic syndrome characterized by less than 5% myeloblasts in the bone marrow, but with 15% or greater red cell precursors in the marrow being abnormal iron-stuffed cells called ringed sideroblasts. Evidence: TAS. Frequency: Very frequent (HP:0040281). (ORPHA:1133)
- Abnormal nasal morphology (HP:0005105). Evidence: TAS. Frequency: Very frequent (HP:0040281). (ORPHA:1133)
- Type II diabetes mellitus (HP:0005978): A type of diabetes mellitus initially characterized by insulin resistance and hyperinsulinemia and subsequently by glucose interolerance and hyperglycemia. Evidence: TAS. Frequency: Very frequent (HP:0040281). (ORPHA:1133)
- Advanced eruption of teeth (HP:0006288): Premature tooth eruption, which can be defined as tooth eruption more than 2 SD earlier than the mean eruption age. Evidence: TAS. Frequency: Very frequent (HP:0040281). (ORPHA:1133)
- Abnormal tragus morphology (HP:0009912): An abnormality of the tragus. Evidence: TAS. Frequency: Very frequent (HP:0040281). (ORPHA:1133)
- Aplasia/Hypoplasia of the breasts (HP:0010311): Absence or underdevelopment of the breasts. Evidence: TAS. Frequency: Very frequent (HP:0040281). (ORPHA:1133)
- Lipoatrophy (HP:0100578): Localized loss of fat tissue. Evidence: TAS. Frequency: Very frequent (HP:0040281). (ORPHA:1133)
- Type I diabetes mellitus (HP:0100651): A chronic condition in which the pancreas produces little or no insulin. Type I diabetes mellitus is manifested by the sudden onset of severe hyperglycemia with rapid progression to diabetic ketoacidosis unless treated with insulin. Evidence: TAS. Frequency: Very frequent (HP:0040281). (ORPHA:1133)
- Aplasia/Hypoplasia of the eyebrow (HP:0100840): Absence or underdevelopment of the eyebrow. Evidence: TAS. Frequency: Very frequent (HP:0040281). (ORPHA:1133)
These phenotypes are associated with the disease AREDYLD syndrome (ORPHA:1133).